- Tinnitus (HP:0000360): Tinnitus is an auditory perception that can be described as the experience of sound, in the ear or in the head, in the absence of external acoustic stimulation. Evidence: TAS. Frequency: Frequent (HP:0040282). (ORPHA:97286)
- Hearing impairment (HP:0000365): A decreased magnitude of the sensory perception of sound. Evidence: TAS. Frequency: Frequent (HP:0040282). (ORPHA:97286)
- Weight loss (HP:0001824): Reduction of total body weight. Evidence: TAS. Frequency: Frequent (HP:0040282). (ORPHA:97286)
- Dysphagia (HP:0002015): Difficulty in swallowing. Evidence: TAS. Frequency: Frequent (HP:0040282). (ORPHA:97286)
- Abdominal pain (HP:0002027): An unpleasant sensation characterized by physical discomfort (such as pricking, throbbing, or aching) and perceived to originate in the abdomen. Evidence: TAS. Frequency: Frequent (HP:0040282). (ORPHA:97286)
- Gastrointestinal hemorrhage (HP:0002239): Hemorrhage affecting the gastrointestinal tract. Evidence: TAS. Frequency: Frequent (HP:0040282). (ORPHA:97286)
- Paraganglioma (HP:0002668): A carotid body tumor (also called paraganglionoma or chemodectoma) is a tumor found in the upper neck at the branching of the carotid artery. They arise from the chemoreceptor organ (paraganglion) located in the adventitia of the carotid artery bifurcation. Evidence: TAS. Frequency: Very frequent (HP:0040281). (ORPHA:97286)
- Intestinal obstruction (HP:0005214): Blockage or impairment of the normal flow of the contents of the intestine towards the anal canal. Evidence: TAS. Frequency: Frequent (HP:0040282). (ORPHA:97286)
- Cranial nerve paralysis (HP:0006824). Evidence: TAS. Frequency: Frequent (HP:0040282). (ORPHA:97286)
- Gastrointestinal stroma tumor (HP:0100723). Evidence: TAS. Frequency: Very frequent (HP:0040281). (ORPHA:97286)
These phenotypes are associated with the disease Carney-Stratakis syndrome (ORPHA:97286).